Phenotypes associated with the disease CYANIDE, INABILITY TO SMELL (OMIM:304300):
- Abnormality of the face (HP:0000271): An abnormality of the face. Evidence: IEA. (OMIM:304300)
- X-linked recessive inheritance (HP:0001419): A mode of inheritance that is observed for recessive traits related to a gene encoded on the X chromosome. In the context of medical genetics, X-linked recessive disorders manifest in males (who have one copy of the X chromosome and are thus hemizygotes), but generally not in female heterozygotes who have one mutant and one normal allele. Evidence: TAS. (OMIM:304300)